Phenotypes associated with the disease Parathyroid carcinoma (ORPHA:143):
- Hypercalcemia (HP:0003072): The concentration of calcium in the blood circulation is above the upper limit of normal. Evidence: TAS. Frequency: Obligate (HP:0040280). (ORPHA:143)
- Parathyroid carcinoma (HP:0006780): A malignancy of the parathyroid glands. Parathyroid carcinoma usually secretes parathyroid hormone, leading to hyperparathyroidism. Evidence: TAS. Frequency: Obligate (HP:0040280). (ORPHA:143)
- Primary hyperparathyroidism (HP:0008200): A type of hyperparathyroidism caused by a primary abnormality of the parathyroid glands (e.g., adenoma, carcinoma, hyperplasia). Primary hyperparathyroidism is associated with hyercalcemia. Evidence: TAS. Frequency: Obligate (HP:0040280). (ORPHA:143)
- Hypophosphatemia (HP:0002148): The concentration of phosphate ion in the blood circulation is below the lower limit of normal. Evidence: TAS. Frequency: Very frequent (HP:0040281). (ORPHA:143)
- Hypercalciuria (HP:0002150). Evidence: TAS. Frequency: Very frequent (HP:0040281). (ORPHA:143)
- Elevated circulating parathyroid hormone level (HP:0003165): An abnormal increased concentration of parathyroid hormone. Evidence: TAS. Frequency: Very frequent (HP:0040281). (ORPHA:143)
- Abnormal parathyroid morphology (HP:0011766): A structural abnormality of the parathyroid gland. Evidence: TAS. Frequency: Very frequent (HP:0040281). (ORPHA:143)
- Nephrocalcinosis (HP:0000121): Nephrocalcinosis is the deposition of calcium salts in renal parenchyma. Evidence: TAS. Frequency: Frequent (HP:0040282). (ORPHA:143)
- Uterine leiomyoma (HP:0000131): The presence of a leiomyoma of the uterus. Evidence: TAS. Frequency: Frequent (HP:0040282). (ORPHA:143)
- Kidney stone (HP:0000787): Kidney stones (calculi) are mineral concretions in the renal calyces and pelvis that are found free or attached to the renal papillae. Evidence: TAS. Frequency: Frequent (HP:0040282). (ORPHA:143)
- Osteoporosis (HP:0000939): Osteoporosis is a systemic skeletal disease characterized by low bone density and microarchitectural deterioration of bone tissue with a consequent increase in bone fragility. According to the WHO criteria, osteoporosis is defined as a BMD that lies 2.5 standard deviations or more below the average value for young healthy adults (a T-score below -2.5 SD). Evidence: TAS. Frequency: Frequent (HP:0040282). (ORPHA:143)
- Hoarse voice (HP:0001609): Hoarseness refers to a change in the pitch or quality of the voice, with the voice sounding weak, very breathy, scratchy, or husky. Evidence: TAS. Frequency: Frequent (HP:0040282). (ORPHA:143)
- Weight loss (HP:0001824): Reduction of total body weight. Evidence: TAS. Frequency: Frequent (HP:0040282). (ORPHA:143)
- Polydipsia (HP:0001959): Excessive thirst manifested by excessive fluid intake. Evidence: TAS. Frequency: Frequent (HP:0040282). (ORPHA:143)
- Dysphagia (HP:0002015): Difficulty in swallowing. Evidence: TAS. Frequency: Frequent (HP:0040282). (ORPHA:143)
- Fibroma (HP:0010614): Benign tumors that are composed of fibrous or connective tissue. They can grow in all organs, arising from mesenchyme tissue. The term "fibroblastic" or "fibromatous" is used to describe tumors of the fibrous connective tissue. When the term fibroma is used without modifier, it is usually considered benign, with the term fibrosarcoma reserved for malignant tumors. Evidence: TAS. Frequency: Frequent (HP:0040282). (ORPHA:143)
- Shortened QT interval (HP:0012232): Decreased time between the start of the Q wave and the end of the T wave as measured by the electrocardiogram (EKG). Evidence: TAS. Frequency: Frequent (HP:0040282). (ORPHA:143)
- Fatigue (HP:0012378): A subjective feeling of tiredness characterized by a lack of energy and motivation. Evidence: TAS. Frequency: Frequent (HP:0040282). (ORPHA:143)
- Renal insufficiency (HP:0000083): A reduction in the level of performance of the kidneys in areas of function comprising the concentration of urine, removal of wastes, the maintenance of electrolyte balance, homeostasis of blood pressure, and calcium metabolism. Evidence: TAS. Frequency: Occasional (HP:0040283). (ORPHA:143)
- Renal cyst (HP:0000107): A fluid filled sac in the kidney. Evidence: TAS. Frequency: Occasional (HP:0040283). (ORPHA:143)
- Chondrocalcinosis (HP:0000934): Radiographic evidence of articular calcification that represent calcium pyrophosphate depositions in soft tissue surrounding joints and at the insertions of tendons near joints (Entheses/Sharpey fibers) . Evidence: TAS. Frequency: Occasional (HP:0040283). (ORPHA:143)
- Muscle weakness (HP:0001324): Reduced strength of muscles. Evidence: TAS. Frequency: Occasional (HP:0040283). (ORPHA:143)
- Pancreatitis (HP:0001733): The presence of inflammation in the pancreas. Evidence: TAS. Frequency: Occasional (HP:0040283). (ORPHA:143)
- Nausea and vomiting (HP:0002017): Nausea is a commonly encountered symptom that has been defined as an unpleasant painless subjective feeling that one will imminently vomit. Vomiting has been defined as the forceful expulsion of the contents of the stomach, duodenum, or jejunum through the oral cavity. While nausea and vomiting are often thought to exist on a temporal continuum, this is not always the case. There are situations when severe nausea may be present without emesis and less frequently, when emesis may be present without preceding nausea. Evidence: TAS. Frequency: Occasional (HP:0040283). (ORPHA:143)
- Constipation (HP:0002019): Infrequent or difficult evacuation of feces. Evidence: TAS. Frequency: Occasional (HP:0040283). (ORPHA:143)
- Headache (HP:0002315): Cephalgia, or pain sensed in various parts of the head, not confined to the area of distribution of any nerve. Evidence: TAS. Frequency: Occasional (HP:0040283). (ORPHA:143)
- Episodic abdominal pain (HP:0002574): An intermittent form of abdominal pain. Evidence: TAS. Frequency: Occasional (HP:0040283). (ORPHA:143)
- Bone pain (HP:0002653): An unpleasant sensation characterized by physical discomfort (such as pricking, throbbing, or aching) localized to bone. Evidence: TAS. Frequency: Occasional (HP:0040283). (ORPHA:143)
- Peptic ulcer (HP:0004398): The term peptic ulcer refers to acid peptic injury of the digestive tract, resulting in mucosal break reaching the submucosa. Peptic ulcers are usually located in the stomach or proximal duodenum, but they can also be found in the esophagus or Meckel's diverticulum. Infection with Helicobacter pylori and the use of non steroidal antiinflammatory drugs (NSAIDs) or aspirin are the main risk factors of both gastric and duodenal peptic ulcers. Evidence: TAS. Frequency: Occasional (HP:0040283). (ORPHA:143)
- Renal hamartoma (HP:0008696): A disordered proliferation of mature tissues that are native to the kidneys. Evidence: TAS. Frequency: Occasional (HP:0040283). (ORPHA:143)
- Mandibular pain (HP:0200025): An unpleasant sensation characterized by physical discomfort (such as pricking, throbbing, or aching) localized to the mandible. Evidence: TAS. Frequency: Occasional (HP:0040283). (ORPHA:143)
- Nephroblastoma (HP:0002667): The presence of a nephroblastoma, which is a neoplasm of the kidney that primarily affects children. Evidence: TAS. Frequency: Very rare (HP:0040284). (ORPHA:143)
- Thyroid carcinoma (HP:0002890): The presence of a carcinoma of the thyroid gland. Evidence: TAS. Frequency: Very rare (HP:0040284). (ORPHA:143)
- Pancreatic adenocarcinoma (HP:0006725): The presence of an adenocarcinoma of the pancreas. Evidence: TAS. Frequency: Very rare (HP:0040284). (ORPHA:143)
- Testicular neoplasm (HP:0010788): The presence of a neoplasm of the testis. Evidence: TAS. Frequency: Very rare (HP:0040284). (ORPHA:143)
- Lipoma (HP:0012032): Benign neoplasia derived from lipoblasts or lipocytes of white or brown fat. May be angiomatous or hibernomatous. Evidence: TAS. Frequency: Very rare (HP:0040284). (ORPHA:143)